- Hypermelanotic macule (HP:0001034): A hyperpigmented circumscribed area of change in normal skin color without elevation or depression of any size. Evidence: PCS. Onset: Childhood onset (HP:0011463). (PMID:23519333)
- Hypopigmented macule (HP:0020073): A white or lighter patch of skin that may appear anywhere on the body and are caused by decreased skin pigmentation. Evidence: PCS. Onset: Childhood onset (HP:0011463). (PMID:23519333)
- Childhood onset (HP:0011463): Onset of disease at the age of between 1 and 5 years. Evidence: PCS. (PMID:23519333)
- Autosomal dominant inheritance (HP:0000006): A mode of inheritance that is observed for traits related to a gene encoded on one of the autosomes (i.e., the human chromosomes 1-22) in which a trait manifests in heterozygotes. In the context of medical genetics, an autosomal dominant disorder is caused when a single copy of the mutant allele is present. Males and females are affected equally, and can both transmit the disorder with a risk of 50% for each child of inheriting the mutant allele. Evidence: PCS. (PMID:23519333)
These phenotypes are associated with the disease dyschromatosis universalis hereditaria 3 (OMIM:615402).